Phenotypes associated with the disease Polyneuropathy-intellectual disability-acromicria-premature menopause syndrome (ORPHA:2928):
- Decreased nerve conduction velocity (HP:0000762): A reduction in the speed at which electrical signals propagate along the axon of a neuron. Evidence: TAS. Frequency: Very frequent (HP:0040281). (ORPHA:2928)
- Brachydactyly (HP:0001156): Digits that appear disproportionately short compared to the hand/foot. The word brachydactyly is used here to describe a series distinct patterns of shortened digits (brachydactyly types A-E). This is the sense used here. Evidence: TAS. Frequency: Very frequent (HP:0040281). (ORPHA:2928)
- Intellectual disability (HP:0001249): The term intellectual disability or intellectual developmental disorder is used to describe significantly sub-average intellectual and adaptive functioning based on clinical assessment and as measured by individually administered, appropriately normed, standardized and validated tests of intellectual functioning and adaptive behavior, with onset during the developmental period from infancy through adolescence. Evidence: TAS. Frequency: Very frequent (HP:0040281). (ORPHA:2928)
- Gait disturbance (HP:0001288): The term gait disturbance can refer to any disruption of the ability to walk. Evidence: TAS. Frequency: Very frequent (HP:0040281). (ORPHA:2928)
- Diminished deep tendon reflex (HP:0001315): A reduction (hyporeflexia) or complete absence (areflexia) of the involuntary muscle contraction normally elicited by a reflex stimulus, such as tapping a deep tendon. Evidence: TAS. Frequency: Very frequent (HP:0040281). (ORPHA:2928)
- Muscle weakness (HP:0001324): Reduced strength of muscles. Evidence: TAS. Frequency: Very frequent (HP:0040281). (ORPHA:2928)
- Micromelia (HP:0002983): The presence of abnormally small extremities. Evidence: TAS. Frequency: Very frequent (HP:0040281). (ORPHA:2928)
- EMG abnormality (HP:0003457): Abnormal results of investigations using electromyography (EMG). Evidence: TAS. Frequency: Very frequent (HP:0040281). (ORPHA:2928)
- Short stature (HP:0004322): A height below that which is expected according to age and gender norms. Although there is no universally accepted definition of short stature, many refer to "short stature" as height more than 2 standard deviations below the mean for age and gender (or below the 3rd percentile for age and gender dependent norms). Evidence: TAS. Frequency: Very frequent (HP:0040281). (ORPHA:2928)
- Truncal obesity (HP:0001956): Obesity located preferentially in the trunk of the body as opposed to the extremities. Evidence: TAS. Frequency: Frequent (HP:0040282). (ORPHA:2928)
- Ulnar deviation of finger (HP:0009465): Bending or curvature of a finger toward the ulnar side (i.e., away from the thumb). The deviation is at the metacarpal-phalangeal joint, and this finding is distinct from clinodactyly. Evidence: TAS. Frequency: Frequent (HP:0040282). (ORPHA:2928)
- Camptodactyly of finger (HP:0100490): The distal interphalangeal joint and/or the proximal interphalangeal joint of the fingers cannot be extended to 180 degrees by either active or passive extension. Evidence: TAS. Frequency: Frequent (HP:0040282). (ORPHA:2928)
- Furrowed tongue (HP:0000221): Accentuation of the grooves on the dorsal surface of the tongue. Evidence: TAS. Frequency: Occasional (HP:0040283). (ORPHA:2928)
- Abnormal pelvic girdle bone morphology (HP:0002644): An abnormality of the bony pelvic girdle, which is a ring of bones connecting the vertebral column to the femurs. Evidence: TAS. Frequency: Occasional (HP:0040283). (ORPHA:2928)
- Arrhythmia (HP:0011675): Any cardiac rhythm other than the normal sinus rhythm. Such a rhythm may be either of sinus or ectopic origin and either regular or irregular. An arrhythmia may be due to a disturbance in impulse formation or conduction or both. Evidence: TAS. Frequency: Occasional (HP:0040283). (ORPHA:2928)